Phenotypes associated with the disease Spinocerebellar ataxia type 29 (ORPHA:208513):
- Delayed speech and language development (HP:0000750): A degree of language development that is significantly below the norm for a child of a specified age. Evidence: TAS. Frequency: Very frequent (HP:0040281). (ORPHA:208513)
- Dysarthria (HP:0001260): Dysarthric speech is a general description referring to a neurological speech disorder characterized by poor articulation. Depending on the involved neurological structures, dysarthria may be further classified as spastic, flaccid, ataxic, hyperkinetic and hypokinetic, or mixed. Evidence: TAS. Frequency: Very frequent (HP:0040281). (ORPHA:208513)
- Dysmetria (HP:0001310): A type of ataxia characterized by the inability to carry out movements with the correct range and motion across the plane of more than one joint related to incorrect estimation of the distances required for targeted movements. Evidence: TAS. Frequency: Very frequent (HP:0040281). (ORPHA:208513)
- Gait ataxia (HP:0002066): A type of ataxia characterized by the impairment of the ability to coordinate the movements required for normal walking. Gait ataxia is characteirzed by a wide-based staggering gait with a tendency to fall. Evidence: TAS. Frequency: Very frequent (HP:0040281). (ORPHA:208513)
- Intention tremor (HP:0002080): A type of kinetic tremor that occurs during target directed movement is called intention tremor. That is, an oscillatory cerebellar ataxia that tends to be absent when the limbs are inactive and during the first part of voluntary movement but worsening as the movement continues and greater precision is required (e.g., in touching a target such as the patient's nose or a physician's finger). Evidence: TAS. Frequency: Very frequent (HP:0040281). (ORPHA:208513)
- Delayed gross motor development (HP:0002194): A type of motor delay characterized by a delay in acquiring the ability to control the large muscles of the body for walking, running, sitting, and crawling. Evidence: TAS. Frequency: Very frequent (HP:0040281). (ORPHA:208513)
- Delayed fine motor development (HP:0010862): A type of motor delay characterized by a delay in acquiring the ability to control the fingers and hands. Evidence: TAS. Frequency: Very frequent (HP:0040281). (ORPHA:208513)
- Abnormal saccadic eye movements (HP:0000570): An abnormality of eye movement characterized by impairment of fast (saccadic) eye movements. Evidence: TAS. Frequency: Frequent (HP:0040282). (ORPHA:208513)
- Nystagmus (HP:0000639): Rhythmic, involuntary oscillations of one or both eyes related to abnormality in fixation, conjugate gaze, or vestibular mechanisms. Evidence: TAS. Frequency: Frequent (HP:0040282). (ORPHA:208513)
- Oculomotor apraxia (HP:0000657): Ocular motor apraxia is a deficiency in voluntary, horizontal, lateral, fast eye movements (saccades) with retention of slow pursuit movements. The inability to follow objects visually is often compensated by head movements. There may be decreased smooth pursuit, and cancelation of the vestibulo-ocular reflex. Evidence: TAS. Frequency: Frequent (HP:0040282). (ORPHA:208513)
- Motor delay (HP:0001270): A type of Developmental delay characterized by a delay in acquiring motor skills. Evidence: TAS. Frequency: Frequent (HP:0040282). (ORPHA:208513)
- Cerebellar atrophy (HP:0001272): Cerebellar atrophy is defined as a cerebellum with initially normal structures, in a posterior fossa with normal size, which displays enlarged fissures (interfolial spaces) in comparison to the foliae secondary to loss of tissue. Cerebellar atrophy implies irreversible loss of tissue and result from an ongoing progressive disease until a final stage is reached or a single injury, e.g. an intoxication or infectious event. Evidence: TAS. Frequency: Frequent (HP:0040282). (ORPHA:208513)
- Generalized hypotonia (HP:0001290): Generalized muscular hypotonia (abnormally low muscle tone). Evidence: TAS. Frequency: Frequent (HP:0040282). (ORPHA:208513)
- Dysdiadochokinesis (HP:0002075): A type of ataxia characterized by the impairment of the ability to perform rapidly alternating movements, such as pronating and supinating his or her hand on the dorsum of the other hand as rapidly as possible. Evidence: TAS. Frequency: Frequent (HP:0040282). (ORPHA:208513)
- Cerebellar vermis atrophy (HP:0006855): Wasting (atrophy) of the vermis of cerebellum. Evidence: TAS. Frequency: Frequent (HP:0040282). (ORPHA:208513)
- Delayed early-childhood social milestone development (HP:0012434): A failure to meet one or more age-related milestones of social behavior. Evidence: TAS. Frequency: Frequent (HP:0040282). (ORPHA:208513)
- Cognitive impairment (HP:0100543): Abnormal cognition is characterized by deficits in thinking, reasoning, or remembering. Evidence: TAS. Frequency: Frequent (HP:0040282). (ORPHA:208513)
- Ataxia (HP:0001251): Ataxia refers to impaired coordination of voluntary muscle movement. Cerebellar ataxia refers to ataxia due to dysfunction of the cerebellum. This causes a variety of elementary neurological deficits including asynergy (lack of coordination between muscles, limbs and joints), dysmetria (lack of ability to judge distances that can lead to under- or overshoot in grasping movements), and dysdiadochokinesia (inability to perform rapid movements requiring antagonizing muscle groups to be switched on and off repeatedly). Evidence: TAS. Frequency: Occasional (HP:0040283). (ORPHA:208513)
- Global developmental delay (HP:0001263): A delay in the achievement of motor or mental milestones in the domains of development of a child, including motor skills, speech and language, cognitive skills, and social and emotional skills. This term should only be used to describe children younger than five years of age. Evidence: TAS. Frequency: Occasional (HP:0040283). (ORPHA:208513)
- Visual fixation instability (HP:0025405): A deficit in the ability to fixate eye movements in order to stabilize images on the retina. Evidence: TAS. Frequency: Occasional (HP:0040283). (ORPHA:208513)